Phenotypes associated with the disease FOXG1 syndrome (ORPHA:561854):
- Progressive microcephaly (HP:0000253): Progressive microcephaly is diagnosed when the head circumference falls progressively behind age- and gender-dependent norms. Evidence: TAS. Frequency: Very frequent (HP:0040281). (ORPHA:561854)
- Strabismus (HP:0000486): A misalignment of the eyes so that the visual axes deviate from bifoveal fixation. The classification of strabismus may be based on a number of features including the relative position of the eyes, whether the deviation is latent or manifest, intermittent or constant, concomitant or otherwise and according to the age of onset and the relevance of any associated refractive error. Evidence: TAS. Frequency: Very frequent (HP:0040281). (ORPHA:561854)
- Motor stereotypy (HP:0000733): Use of the same abnormal action in response to certain triggers or at random. They may be used as a way to regulate one's internal state but must otherwise have no apparent functional purpose. Evidence: TAS. Frequency: Very frequent (HP:0040281). (ORPHA:561854)
- Hypotonia (HP:0001252): Hypotonia is an abnormally low muscle tone (the amount of tension or resistance to movement in a muscle). Even when relaxed, muscles have a continuous and passive partial contraction which provides some resistance to passive stretching. Hypotonia thus manifests as diminished resistance to passive stretching. Hypotonia is not the same as muscle weakness, although the two conditions can co-exist. Evidence: TAS. Frequency: Very frequent (HP:0040281). (ORPHA:561854)
- Motor delay (HP:0001270): A type of Developmental delay characterized by a delay in acquiring motor skills. Evidence: TAS. Frequency: Very frequent (HP:0040281). (ORPHA:561854)
- Gait disturbance (HP:0001288): The term gait disturbance can refer to any disruption of the ability to walk. Evidence: TAS. Frequency: Very frequent (HP:0040281). (ORPHA:561854)
- Feeding difficulties (HP:0011968): Impaired ability to eat related to problems gathering food and getting ready to suck, chew, or swallow it. Evidence: TAS. Frequency: Very frequent (HP:0040281). (ORPHA:561854)
- Dyskinesia (HP:0100660): A movement disorder which consists of effects including diminished voluntary movements and the presence of involuntary movements. Evidence: TAS. Frequency: Very frequent (HP:0040281). (ORPHA:561854)
- Visual impairment (HP:0000505): Visual impairment (or vision impairment) is vision loss (of a person) to such a degree as to qualify as an additional support need through a significant limitation of visual capability resulting from either disease, trauma, or congenital or degenerative conditions that cannot be corrected by conventional means, such as refractive correction, medication, or surgery. Evidence: TAS. Frequency: Frequent (HP:0040282). (ORPHA:561854)
- Autistic behavior (HP:0000729): Persistent deficits in social interaction and communication and interaction as well as a markedly restricted repertoire of activity and interest as well as repetitive patterns of behavior. Evidence: TAS. Frequency: Frequent (HP:0040282). (ORPHA:561854)
- Paroxysmal bursts of laughter (HP:0000749). Evidence: TAS. Frequency: Frequent (HP:0040282). (ORPHA:561854)
- Reduced eye contact (HP:0000817): A reduced frequency or duration of eye contact. Evidence: TAS. Frequency: Frequent (HP:0040282). (ORPHA:561854)
- Spasticity (HP:0001257): A motor disorder characterized by a velocity-dependent increase in tonic stretch reflexes with increased muscle tone, exaggerated (hyperexcitable) tendon reflexes. Evidence: TAS. Frequency: Frequent (HP:0040282). (ORPHA:561854)
- Choreoathetosis (HP:0001266): Involuntary movements characterized by both athetosis (inability to sustain muscles in a fixed position) and chorea (widespread jerky arrhythmic movements). Evidence: TAS. Frequency: Frequent (HP:0040282). (ORPHA:561854)
- Abnormal corpus callosum morphology (HP:0001273): Abnormality of the corpus callosum. Evidence: TAS. Frequency: Frequent (HP:0040282). (ORPHA:561854)
- Dystonia (HP:0001332): An abnormally increased muscular tone that causes fixed abnormal postures. There is a slow, intermittent twisting motion that leads to exaggerated turning and posture of the extremities and trunk. Evidence: TAS. Frequency: Frequent (HP:0040282). (ORPHA:561854)
- Myoclonus (HP:0001336): Very brief, involuntary random muscular contractions occurring at rest, in response to sensory stimuli, or accompanying voluntary movements. Evidence: TAS. Frequency: Frequent (HP:0040282). (ORPHA:561854)
- Absent speech (HP:0001344): Complete lack of development of speech and language abilities. Evidence: TAS. Frequency: Frequent (HP:0040282). (ORPHA:561854)
- Constipation (HP:0002019): Infrequent or difficult evacuation of feces. Evidence: TAS. Frequency: Frequent (HP:0040282). (ORPHA:561854)
- Gastroesophageal reflux (HP:0002020): A condition in which the stomach contents leak backwards from the stomach into the esophagus through the lower esophageal sphincter. Evidence: TAS. Frequency: Frequent (HP:0040282). (ORPHA:561854)
- Bilateral tonic-clonic seizure (HP:0002069): A bilateral tonic-clonic seizure is a seizure defined by a tonic (bilateral increased tone, lasting seconds to minutes) and then a clonic (bilateral sustained rhythmic jerking) phase. Evidence: TAS. Frequency: Frequent (HP:0040282). (ORPHA:561854)
- Orofacial dyskinesia (HP:0002310). Evidence: TAS. Frequency: Frequent (HP:0040282). (ORPHA:561854)
- Sleep disturbance (HP:0002360): An abnormal pattern in the quality, quantity, or characteristics of sleep. Evidence: TAS. Frequency: Frequent (HP:0040282). (ORPHA:561854)
- Hyperkinetic movements (HP:0002487): Motor hyperactivity with excessive movement of muscles of the body as a whole. Evidence: TAS. Frequency: Frequent (HP:0040282). (ORPHA:561854)
- Bruxism (HP:0003763): Bruxism is characterized by the grinding of the teeth including the clenching of the jaw and typically occur during sleep. Evidence: TAS. Frequency: Frequent (HP:0040282). (ORPHA:561854)
- Excessive salivation (HP:0003781): Excessive production of saliva. Evidence: TAS. Frequency: Frequent (HP:0040282). (ORPHA:561854)
- Short stature (HP:0004322): A height below that which is expected according to age and gender norms. Although there is no universally accepted definition of short stature, many refer to "short stature" as height more than 2 standard deviations below the mean for age and gender (or below the 3rd percentile for age and gender dependent norms). Evidence: TAS. Frequency: Frequent (HP:0040282). (ORPHA:561854)
- Decreased body weight (HP:0004325): Abnormally low body weight. Evidence: TAS. Frequency: Frequent (HP:0040282). (ORPHA:561854)
- Focal-onset seizure (HP:0007359): A focal-onset seizure is a type of seizure originating within networks limited to one hemisphere. They may be discretely localized or more widely distributed, and may originate in subcortical structures. Evidence: TAS. Frequency: Frequent (HP:0040282). (ORPHA:561854)
- Severe postnatal growth retardation (HP:0008850): Severely slow or limited growth after birth, being four standard deviations or more below age- and sex-related norms. Evidence: TAS. Frequency: Frequent (HP:0040282). (ORPHA:561854)
- Severe global developmental delay (HP:0011344): A severe delay in the achievement of motor or mental milestones in the domains of development of a child. Evidence: TAS. Frequency: Frequent (HP:0040282). (ORPHA:561854)
- Delayed myelination (HP:0012448): Delayed myelination. Evidence: TAS. Frequency: Frequent (HP:0040282). (ORPHA:561854)
- Infantile spasms (HP:0012469): Infantile spasms represent a subset of "epileptic spasms". Infantile Spasms are epileptic spasms starting in the first year of life (infancy). Evidence: TAS. Frequency: Frequent (HP:0040282). (ORPHA:561854)
- Inappropriate crying (HP:0030215): Uncontrolled episodes of crying occur without any apparent motivating stimuli. Evidence: TAS. Frequency: Frequent (HP:0040282). (ORPHA:561854)
- Abnormality of movement (HP:0100022): An abnormality of movement with a neurological basis characterized by changes in coordination and speed of voluntary movements. Evidence: TAS. Frequency: Frequent (HP:0040282). (ORPHA:561854)
- Cognitive impairment (HP:0100543): Abnormal cognition is characterized by deficits in thinking, reasoning, or remembering. Evidence: TAS. Frequency: Frequent (HP:0040282). (ORPHA:561854)
- Agenesis of corpus callosum (HP:0001274): Absence of the corpus callosum as a result of the failure of the corpus callosum to develop, which can be the result of a failure in any one of the multiple steps of callosal development including cellular proliferation and migration, axonal growth or glial patterning at the midline. Evidence: TAS. Frequency: Occasional (HP:0040283). (ORPHA:561854)
- Pachygyria (HP:0001302): Pachygyria is a malformation of cortical development with abnormally wide gyri with sulci 1,5-3 cm apart and abnormally thick cortex measuring more than 5 mm (radiological definition). See also neuropathological definitions for 2-, 3-, and 4-layered lissencephaly. Evidence: TAS. Frequency: Occasional (HP:0040283). (ORPHA:561854)
- Hypoplasia of the corpus callosum (HP:0002079): Underdevelopment of the corpus callosum. Evidence: TAS. Frequency: Occasional (HP:0040283). (ORPHA:561854)
- Developmental regression (HP:0002376): Loss of developmental skills, as manifested by loss of developmental milestones. Evidence: TAS. Frequency: Occasional (HP:0040283). (ORPHA:561854)
- Poor speech (HP:0002465). Evidence: TAS. Frequency: Occasional (HP:0040283). (ORPHA:561854)
- Inability to walk (HP:0002540): Incapability to ambulate. Evidence: TAS. Frequency: Occasional (HP:0040283). (ORPHA:561854)
- Scoliosis (HP:0002650): The presence of an abnormal lateral curvature of the spine. Evidence: TAS. Frequency: Occasional (HP:0040283). (ORPHA:561854)
- Kyphoscoliosis (HP:0002751): An abnormal curvature of the spine in both a coronal (lateral) and sagittal (back-to-front) plane. Evidence: TAS. Frequency: Occasional (HP:0040283). (ORPHA:561854)
- Abnormal respiratory system physiology (HP:0002795): Abnormal function of the respiratory system. Evidence: TAS. Frequency: Occasional (HP:0040283). (ORPHA:561854)
- Optic disc hypoplasia (HP:0007766): Underdevelopment of the optic disc, that is of the optic nerve head, where ganglion cell axons exit the eye to form the optic nerve. Evidence: TAS. Frequency: Occasional (HP:0040283). (ORPHA:561854)
- Reduced social responsiveness (HP:0012760): A reduced ability to participate in the back-and-forth flow of social interaction appropriate to culture and developmental level, which is normally characterized by an influence of the behavior of one person on the behavior of another person. This results in difficulty interacting with others through emotional, physical, or verbal communication. Evidence: TAS. Frequency: Occasional (HP:0040283). (ORPHA:561854)
- Status epilepticus (HP:0002133): Status epilepticus is a type of prolonged seizure resulting either from the failure of the mechanisms responsible for seizure termination or from the initiation of mechanisms which lead to abnormally prolonged seizures (after time point t1). It is a condition that can have long-term consequences (after time point t2), including neuronal death, neuronal injury, and alteration of neuronal networks, depending on the type and duration of seizures. Evidence: TAS. Frequency: Very rare (HP:0040284). (ORPHA:561854)
- Stereotypical hand wringing (HP:0012171): Habitual clasping and wringing of the hands in the middle of the body, similar to a hand-washing movement. Evidence: TAS. Frequency: Very rare (HP:0040284). (ORPHA:561854)